Phenotypes associated with the disease acetyl-CoA acetyltransferase-2 deficiency (OMIM:614055):
- Increased circulating pyruvate concentration (HP:0003542): The concentration of pyruvate in the blood circulation is above the upper limit of normal. Evidence: TAS. (OMIM:614055)
- Increased circulating lactate concentration (HP:0002151): Abnormally increased level of blood lactate (2-hydroxypropanoic acid). Lactate is produced from pyruvate by lactate dehydrogenase during normal metabolism. The terms lactate and lactic acid are often used interchangeably but lactate (the component measured in blood) is strictly a weak base whereas lactic acid is the corresponding acid. Lactic acidosis is often used clinically to describe elevated lactate but should be reserved for cases where there is a corresponding acidosis (pH below 7.35). Evidence: TAS. (OMIM:614055)
- Global developmental delay (HP:0001263): A delay in the achievement of motor or mental milestones in the domains of development of a child, including motor skills, speech and language, cognitive skills, and social and emotional skills. This term should only be used to describe children younger than five years of age. Evidence: TAS. (OMIM:614055)
- Hypotonia (HP:0001252): Hypotonia is an abnormally low muscle tone (the amount of tension or resistance to movement in a muscle). Even when relaxed, muscles have a continuous and passive partial contraction which provides some resistance to passive stretching. Hypotonia thus manifests as diminished resistance to passive stretching. Hypotonia is not the same as muscle weakness, although the two conditions can co-exist. Evidence: TAS. (OMIM:614055)
- Chorea (HP:0002072): Chorea (Greek for 'dance') refers to widespread arrhythmic involuntary movements of a forcible, jerky and restless fashion. It is a random-appearing sequence of one or more discrete involuntary movements or movement fragments. Movements appear random because of variability in timing, duration or location. Each movement may have a distinct start and end. However, movements may be strung together and thus may appear to flow randomly from one muscle group to another. Chorea can involve the trunk, neck, face, tongue, and extremities. Evidence: TAS. (OMIM:614055)
- Generalized hypotonia (HP:0001290): Generalized muscular hypotonia (abnormally low muscle tone). Evidence: TAS. (OMIM:614055)
- Sporadic (HP:0003745): Cases of the disease in question occur without a previous family history, i.e., as isolated cases without being transmitted from a parent and without other siblings being affected. Evidence: TAS. (OMIM:614055)